Phenotypes associated with the disease prostate cancer, hereditary, X-linked 1 (OMIM:300147):
- X-linked inheritance (HP:0001417): A mode of inheritance that is observed for traits related to a gene encoded on the X chromosome. Evidence: IEA. (OMIM:300147)
- Prostate cancer (HP:0012125): A cancer of the prostate. Evidence: IEA. (OMIM:300147)